- Abnormality of metabolism/homeostasis (HP:0001939). Evidence: IEA. (OMIM:274900)
- Autosomal recessive inheritance (HP:0000007): A mode of inheritance that is observed for traits related to a gene encoded on one of the autosomes (i.e., the human chromosomes 1-22) in which a trait manifests in individuals with two pathogenic alleles, either homozygotes (two copies of the same mutant allele) or compound heterozygotes (whereby each copy of a gene has a distinct mutant allele). Evidence: IEA. (OMIM:274900)
- Hypothyroidism (HP:0000821): Deficiency of thyroid hormone. Evidence: IEA. (OMIM:274900)
- Growth delay (HP:0001510): A deficiency or slowing down of growth pre- and postnatally. Evidence: IEA. (OMIM:274900)
- Goiter (HP:0000853): An enlargement of the thyroid gland. Evidence: IEA. (OMIM:274900)
- Intellectual disability (HP:0001249): The term intellectual disability or intellectual developmental disorder is used to describe significantly sub-average intellectual and adaptive functioning based on clinical assessment and as measured by individually administered, appropriately normed, standardized and validated tests of intellectual functioning and adaptive behavior, with onset during the developmental period from infancy through adolescence. Evidence: IEA. (OMIM:274900)
These phenotypes are associated with the disease thyroid dyshormonogenesis 5 (OMIM:274900).